Phenotypes associated with the disease congenital disorder of glycosylation, type IAA (OMIM:617082):
- Bilateral tonic-clonic seizure (HP:0002069): A bilateral tonic-clonic seizure is a seizure defined by a tonic (bilateral increased tone, lasting seconds to minutes) and then a clonic (bilateral sustained rhythmic jerking) phase. Evidence: PCS. Frequency: 2/2. (PMID:25066056)
- Axial hypotonia (HP:0008936): Muscular hypotonia (abnormally low muscle tone) affecting the musculature of the trunk. Evidence: PCS. Frequency: 2/2. (PMID:25066056)
- Congenital onset (HP:0003577): A phenotypic abnormality that is present at birth. Evidence: PCS. Frequency: 2/2. (PMID:25066056)
- Microcephaly (HP:0000252): Head circumference below 2 standard deviations below the mean for age and gender. Evidence: PCS. Frequency: 2/2. (PMID:25066056)
- Hearing impairment (HP:0000365): A decreased magnitude of the sensory perception of sound. Evidence: PCS. Frequency: 1/1. (PMID:25066056)
- Scoliosis (HP:0002650): The presence of an abnormal lateral curvature of the spine. Evidence: PCS. Frequency: 2/2. Onset: Congenital onset (HP:0003577). (PMID:25066056)
- Status epilepticus (HP:0002133): Status epilepticus is a type of prolonged seizure resulting either from the failure of the mechanisms responsible for seizure termination or from the initiation of mechanisms which lead to abnormally prolonged seizures (after time point t1). It is a condition that can have long-term consequences (after time point t2), including neuronal death, neuronal injury, and alteration of neuronal networks, depending on the type and duration of seizures. Evidence: PCS. Frequency: 2/2. (PMID:25066056)
- Cerebral cortical atrophy (HP:0002120): Atrophy of the cortex of the cerebrum. Evidence: PCS. Frequency: 1/1. (PMID:25066056)
- Global developmental delay (HP:0001263): A delay in the achievement of motor or mental milestones in the domains of development of a child, including motor skills, speech and language, cognitive skills, and social and emotional skills. This term should only be used to describe children younger than five years of age. Evidence: PCS. Frequency: 2/2. (PMID:25066056)
- Generalized hypotonia (HP:0001290): Generalized muscular hypotonia (abnormally low muscle tone). Evidence: PCS. Frequency: 2/2. Onset: Congenital onset (HP:0003577). (PMID:25066056)
- Failure to thrive (HP:0001508): Failure to thrive (FTT) refers to a child whose physical growth is substantially below the norm. Evidence: PCS. Frequency: 1/2. (PMID:25066056)
- Appendicular spasticity (HP:0034353): A type of spasticity that affects one or more limbs (arms or legs). Evidence: PCS. Frequency: 2/2. (PMID:25066056)
- Cerebral visual impairment (HP:0100704): A form of loss of vision caused by damage to the visual cortex rather than a defect in the eye. Evidence: PCS. Frequency: 1/1. (PMID:25066056)
- Hypertrichosis (HP:0000998): Hypertrichosis is increased hair growth that is abnormal in quantity or location. Evidence: PCS. Frequency: 1/2. (PMID:25066056)
- Pseudobulbar paralysis (HP:0007024): Bilateral impairment of the function of the cranial nerves 9-12, which control musculature involved in eating, swallowing, and speech. Pseudobulbar paralysis is characterized clinically by dysarthria, dysphonia, and dysphagia with bifacial paralysis, and may be accompanied by Pseudobulbar behavioral symptoms such as enforced crying and laughing. Evidence: PCS. Frequency: 1/1. (PMID:25066056)
- Autosomal recessive inheritance (HP:0000007): A mode of inheritance that is observed for traits related to a gene encoded on one of the autosomes (i.e., the human chromosomes 1-22) in which a trait manifests in individuals with two pathogenic alleles, either homozygotes (two copies of the same mutant allele) or compound heterozygotes (whereby each copy of a gene has a distinct mutant allele). Evidence: PCS. (PMID:25066056)
- Intrauterine growth retardation (HP:0001511): An abnormal restriction of fetal growth with fetal weight below the tenth percentile for gestational age. Evidence: PCS. Frequency: 1/2. (PMID:25066056)
- Optic disc pallor (HP:0000543): A pale yellow discoloration of the optic disc (the area of the optic nerve head in the retina). The optic disc normally has a pinkish hue with a central yellowish depression. Evidence: PCS. Frequency: 1/1. (PMID:25066056)
- Attenuation of retinal blood vessels (HP:0007843): Narrowing of the retinal blood vessels, both arterioles and venules. Evidence: PCS. Frequency: 1/1. (PMID:25066056)